Phenotypes associated with the disease Cerebellar ataxia-ectodermal dysplasia syndrome (ORPHA:1174):
- Inguinal hernia (HP:0000023): Protrusion of the contents of the abdominal cavity through the inguinal canal. Evidence: TAS. Frequency: Frequent (HP:0040282). (ORPHA:1174)
- Cryptorchidism (HP:0000028): Testis in inguinal canal. That is, absence of one or both testes from the scrotum owing to failure of the testis or testes to descend through the inguinal canal to the scrotum. Evidence: TAS. Frequency: Frequent (HP:0040282). (ORPHA:1174)
- Triangular face (HP:0000325): Facial contour, as viewed from the front, triangular in shape, with breadth at the temples and tapering to a narrow chin. Evidence: TAS. Frequency: Very frequent (HP:0040281). (ORPHA:1174)
- Broad forehead (HP:0000337): Width of the forehead or distance between the frontotemporales is more than two standard deviations above the mean (objective); or apparently increased distance between the two sides of the forehead. Evidence: TAS. Frequency: Frequent (HP:0040282). (ORPHA:1174)
- Hypodontia (HP:0000668): The absence of five or less teeth from the normal series by a failure to develop. Evidence: TAS. Frequency: Very frequent (HP:0040281). (ORPHA:1174)
- Microdontia (HP:0000691): Decreased size of the teeth, which can be defined as a mesiodistal tooth diameter (width) more than 2 SD below mean. Alternatively, an apparently decreased maximum width of tooth. Evidence: TAS. Frequency: Very frequent (HP:0040281). (ORPHA:1174)
- Ataxia (HP:0001251): Ataxia refers to impaired coordination of voluntary muscle movement. Cerebellar ataxia refers to ataxia due to dysfunction of the cerebellum. This causes a variety of elementary neurological deficits including asynergy (lack of coordination between muscles, limbs and joints), dysmetria (lack of ability to judge distances that can lead to under- or overshoot in grasping movements), and dysdiadochokinesia (inability to perform rapid movements requiring antagonizing muscle groups to be switched on and off repeatedly). Evidence: TAS. Frequency: Very frequent (HP:0040281). (ORPHA:1174)
- Gait disturbance (HP:0001288): The term gait disturbance can refer to any disruption of the ability to walk. Evidence: TAS. Frequency: Very frequent (HP:0040281). (ORPHA:1174)
- Pes cavus (HP:0001761): An increase in height of the medial longitudinal arch of the foot that does not flatten on weight bearing (i.e., a distinctly hollow form of the sole of the foot when it is bearing weight). Evidence: TAS. Frequency: Frequent (HP:0040282). (ORPHA:1174)
- Abnormal speech pattern (HP:0002167): An abnormality in the sound (volume) or cadence (rate) of speech. Evidence: TAS. Frequency: Frequent (HP:0040282). (ORPHA:1174)
- Fine hair (HP:0002213): Hair that is fine or thin to the touch. Evidence: TAS. Frequency: Very frequent (HP:0040281). (ORPHA:1174)
- Sparse hair (HP:0008070): Reduced density of hairs. Evidence: TAS. Frequency: Very frequent (HP:0040281). (ORPHA:1174)